Phenotypes associated with the disease Megalencephaly-severe kyphoscoliosis-overgrowth syndrome (ORPHA:457359):
- Megalencephaly (HP:0001355): Diffuse enlargement of the entire cerebral hemispheres leading to macrocephaly (with or without overlying cortical dysplasia). Evidence: TAS. Frequency: Frequent (HP:0040282). (ORPHA:457359)
- Disproportionate tall stature (HP:0001519): A tall and slim body build with increased arm span to height ratio (>1.05) and a reduced upper-to-lower segment ratio (<0.85), i.e., unusually long arms and legs. The extremities as well as the hands and feet are unusually slim. Evidence: TAS. Frequency: Frequent (HP:0040282). (ORPHA:457359)
- Large for gestational age (HP:0001520): The term large for gestational age applies to babies whose birth weight lies above the 90th percentile for that gestational age. Evidence: TAS. Frequency: Frequent (HP:0040282). (ORPHA:457359)
- Slender build (HP:0001533): Asthenic habitus refers to a slender build with long limbs, an angular profile, and prominent muscles or bones. Evidence: TAS. Frequency: Frequent (HP:0040282). (ORPHA:457359)
- Long foot (HP:0001833): Increased back to front length of the foot. Evidence: TAS. Frequency: Frequent (HP:0040282). (ORPHA:457359)
- Abnormal facial shape (HP:0001999): An abnormal morphology (form) of the face or its components. Evidence: TAS. Frequency: Frequent (HP:0040282). (ORPHA:457359)
- Gait ataxia (HP:0002066): A type of ataxia characterized by the impairment of the ability to coordinate the movements required for normal walking. Gait ataxia is characteirzed by a wide-based staggering gait with a tendency to fall. Evidence: TAS. Frequency: Frequent (HP:0040282). (ORPHA:457359)
- Bilateral tonic-clonic seizure (HP:0002069): A bilateral tonic-clonic seizure is a seizure defined by a tonic (bilateral increased tone, lasting seconds to minutes) and then a clonic (bilateral sustained rhythmic jerking) phase. Evidence: TAS. Frequency: Frequent (HP:0040282). (ORPHA:457359)
- Drooling (HP:0002307): Habitual flow of saliva out of the mouth. Evidence: TAS. Frequency: Frequent (HP:0040282). (ORPHA:457359)
- Kyphoscoliosis (HP:0002751): An abnormal curvature of the spine in both a coronal (lateral) and sagittal (back-to-front) plane. Evidence: TAS. Frequency: Frequent (HP:0040282). (ORPHA:457359)
- Micropenis (HP:0000054): Abnormally small penis. At birth, the normal penis is about 3 cm (stretched length from pubic tubercle to tip of penis) with micropenis less than 2.0-2.5 cm. Evidence: TAS. Frequency: Occasional (HP:0040283). (ORPHA:457359)
- Malar flattening (HP:0000272): Underdevelopment of the malar prominence of the jugal bone (zygomatic bone in mammals), appreciated in profile, frontal view, and/or by palpation. Evidence: TAS. Frequency: Occasional (HP:0040283). (ORPHA:457359)
- Facial hypotonia (HP:0000297): Reduced muscle tone of a muscle that is innervated by the facial nerve (the seventh cranial nerve). Evidence: TAS. Frequency: Occasional (HP:0040283). (ORPHA:457359)
- Triangular face (HP:0000325): Facial contour, as viewed from the front, triangular in shape, with breadth at the temples and tapering to a narrow chin. Evidence: TAS. Frequency: Occasional (HP:0040283). (ORPHA:457359)
- Prominent nasal bridge (HP:0000426): Anterior positioning of the nasal root in comparison to the usual positioning for age. Evidence: TAS. Frequency: Occasional (HP:0040283). (ORPHA:457359)
- Long neck (HP:0000472): Increased inferior-superior length of the neck. Evidence: TAS. Frequency: Occasional (HP:0040283). (ORPHA:457359)
- Shallow orbits (HP:0000586): Reduced depth of the orbits associated with prominent-appearing ocular globes. Evidence: TAS. Frequency: Occasional (HP:0040283). (ORPHA:457359)
- Cerebellar hypoplasia (HP:0001321): Cerebellar hypoplasia is a descriptive term implying a cerebellum with a reduced volume, but a normal shape and is stable over time. Evidence: TAS. Frequency: Occasional (HP:0040283). (ORPHA:457359)
- Communicating hydrocephalus (HP:0001334): A form of hydrocephalus in which there is no visible obstruction to the flow of the cerebrospinal fluid between the ventricles and subarachnoid space. Evidence: TAS. Frequency: Occasional (HP:0040283). (ORPHA:457359)
- Limitation of joint mobility (HP:0001376): A reduction in the freedom of movement of one or more joints. Evidence: TAS. Frequency: Occasional (HP:0040283). (ORPHA:457359)
- Joint hypermobility (HP:0001382): The capability that a joint (or a group of joints) has to move, passively and/or actively, beyond normal limits along physiological axes. Evidence: TAS. Frequency: Occasional (HP:0040283). (ORPHA:457359)
- Asymmetry of the thorax (HP:0001555): Lack of symmetry between the left and right halves of the thorax. Evidence: TAS. Frequency: Occasional (HP:0040283). (ORPHA:457359)
- Pes planus (HP:0001763): A foot where the longitudinal arch of the foot is in contact with the ground or floor when the individual is standing; or, in a patient lying supine, a foot where the arch is in contact with the surface of a flat board pressed against the sole of the foot by the examiner with a pressure similar to that expected from weight bearing; or, the height of the arch is reduced. Evidence: TAS. Frequency: Occasional (HP:0040283). (ORPHA:457359)
- Neonatal hypoglycemia (HP:0001998). Evidence: TAS. Frequency: Occasional (HP:0040283). (ORPHA:457359)
- Ventriculomegaly (HP:0002119): An increase in size of the ventricular system of the brain. Evidence: TAS. Frequency: Occasional (HP:0040283). (ORPHA:457359)
- Cerebral cortical atrophy (HP:0002120): Atrophy of the cortex of the cerebrum. Evidence: TAS. Frequency: Occasional (HP:0040283). (ORPHA:457359)
- Kyphosis (HP:0002808): Exaggerated anterior convexity of the thoracic vertebral column. Evidence: TAS. Frequency: Occasional (HP:0040283). (ORPHA:457359)
- Lumbar hyperlordosis (HP:0002938): An abnormal accentuation of the inward curvature of the spine in the lumbar region. Evidence: TAS. Frequency: Occasional (HP:0040283). (ORPHA:457359)
- Severe expressive language delay (HP:0006863): A severe delay in the acquisition of the ability to use language to communicate needs, wishes, or thoughts. Evidence: TAS. Frequency: Occasional (HP:0040283). (ORPHA:457359)
- Thick corpus callosum (HP:0007074): Increased vertical dimension of the corpus callosum. This feature can be visualized by sagittal sections on magnetic resonance tomography imaging of the brain. Evidence: TAS. Frequency: Occasional (HP:0040283). (ORPHA:457359)
- Diffuse white matter abnormalities (HP:0007204). Evidence: TAS. Frequency: Occasional (HP:0040283). (ORPHA:457359)
- High myopia (HP:0011003): A severe form of myopia with greater than -6.00 diopters. Evidence: TAS. Frequency: Occasional (HP:0040283). (ORPHA:457359)
- Metopic synostosis (HP:0011330): Premature fusion of the metopic suture. Evidence: TAS. Frequency: Occasional (HP:0040283). (ORPHA:457359)
- Reduced social responsiveness (HP:0012760): A reduced ability to participate in the back-and-forth flow of social interaction appropriate to culture and developmental level, which is normally characterized by an influence of the behavior of one person on the behavior of another person. This results in difficulty interacting with others through emotional, physical, or verbal communication. Evidence: TAS. Frequency: Occasional (HP:0040283). (ORPHA:457359)
- Long face (HP:0000276): Facial height (length) is more than 2 standard deviations above the mean (objective); or, an apparent increase in the height (length) of the face (subjective). Evidence: TAS. Frequency: Very frequent (HP:0040281). (ORPHA:457359)
- Hypertelorism (HP:0000316): Interpupillary distance more than 2 SD above the mean (alternatively, the appearance of an increased interpupillary distance or widely spaced eyes). Evidence: TAS. Frequency: Very frequent (HP:0040281). (ORPHA:457359)
- Arachnodactyly (HP:0001166): Abnormally long and slender fingers (spider fingers). Evidence: TAS. Frequency: Very frequent (HP:0040281). (ORPHA:457359)
- Hypotonia (HP:0001252): Hypotonia is an abnormally low muscle tone (the amount of tension or resistance to movement in a muscle). Even when relaxed, muscles have a continuous and passive partial contraction which provides some resistance to passive stretching. Hypotonia thus manifests as diminished resistance to passive stretching. Hypotonia is not the same as muscle weakness, although the two conditions can co-exist. Evidence: TAS. Frequency: Very frequent (HP:0040281). (ORPHA:457359)
- Overgrowth (HP:0001548): Excessive postnatal growth which may comprise increased weight, increased length, and/or increased head circumference. Evidence: TAS. Frequency: Very frequent (HP:0040281). (ORPHA:457359)
- Severe intellectual disability (HP:0010864): Severe intellectual disability (ID) is defined as a type of ID characterized by severely sub-average adaptive functioning and intellectual functioning, with an intelligence quotient (IQ) the range of 20-34. Evidence: TAS. Frequency: Very frequent (HP:0040281). (ORPHA:457359)
- Prominent forehead (HP:0011220): Forward prominence of the entire forehead, due to protrusion of the frontal bone. Evidence: TAS. Frequency: Very frequent (HP:0040281). (ORPHA:457359)
- Broad eyebrow (HP:0011229): Regional increase in the width (height) of the eyebrow. Evidence: TAS. Frequency: Very frequent (HP:0040281). (ORPHA:457359)
- Sparse eyebrow (HP:0045075): Decreased density/number of eyebrow hairs. Evidence: TAS. Frequency: Very frequent (HP:0040281). (ORPHA:457359)
- High palate (HP:0000218): Height of the palate more than 2 SD above the mean (objective) or palatal height at the level of the first permanent molar more than twice the height of the teeth (subjective). Evidence: TAS. Frequency: Frequent (HP:0040282). (ORPHA:457359)
- Macrocephaly (HP:0000256): Occipitofrontal (head) circumference greater than 97th centile compared to appropriate, age matched, sex-matched normal standards. Alternatively, a apparently increased size of the cranium. Evidence: TAS. Frequency: Frequent (HP:0040282). (ORPHA:457359)
- Mandibular prognathia (HP:0000303): Abnormal prominence of the chin related to increased length of the mandible. Evidence: TAS. Frequency: Frequent (HP:0040282). (ORPHA:457359)
- Posteriorly rotated ears (HP:0000358): A type of abnormal location of the ears in which the position of the ears is characterized by posterior rotation (the superior part of the ears is rotated towards the back of the head, and the inferior part of the ears towards the front). Evidence: TAS. Frequency: Frequent (HP:0040282). (ORPHA:457359)
- Macrotia (HP:0000400): Median longitudinal ear length greater than two standard deviations above the mean and median ear width greater than two standard deviations above the mean (objective); or, apparent increase in length and width of the pinna (subjective). Evidence: TAS. Frequency: Frequent (HP:0040282). (ORPHA:457359)
- Downslanted palpebral fissures (HP:0000494): The palpebral fissure inclination is more than two standard deviations below the mean. Evidence: TAS. Frequency: Frequent (HP:0040282). (ORPHA:457359)
- Proptosis (HP:0000520): An eye that is protruding anterior to the plane of the face to a greater extent than is typical. Evidence: TAS. Frequency: Frequent (HP:0040282). (ORPHA:457359)
- Upslanted palpebral fissure (HP:0000582): The palpebral fissure inclination is more than two standard deviations above the mean for age (objective); or, the inclination of the palpebral fissure is greater than typical for age. Evidence: TAS. Frequency: Frequent (HP:0040282). (ORPHA:457359)
- Global developmental delay (HP:0001263): A delay in the achievement of motor or mental milestones in the domains of development of a child, including motor skills, speech and language, cognitive skills, and social and emotional skills. This term should only be used to describe children younger than five years of age. Evidence: TAS. Frequency: Frequent (HP:0040282). (ORPHA:457359)
- Gait disturbance (HP:0001288): The term gait disturbance can refer to any disruption of the ability to walk. Evidence: TAS. Frequency: Frequent (HP:0040282). (ORPHA:457359)
- Absent speech (HP:0001344): Complete lack of development of speech and language abilities. Evidence: TAS. Frequency: Frequent (HP:0040282). (ORPHA:457359)